- Respiratory insufficiency (HP:0002093). Evidence: TAS. Frequency: Very frequent (HP:0040281). (ORPHA:93941)
- Abnormal vertebral body morphology (HP:0003312): Abnormal form of vertebral body, which is the central cylindrical portion of the vertebra that together with other structures such as the vertebral arch, pedicles, laminae, spinous process, transverse processes, and articular facets makes up a vertebra. Evidence: TAS. Frequency: Very frequent (HP:0040281). (ORPHA:93941)
- Cachexia (HP:0004326): Severe weight loss, wasting of muscle, loss of appetite, and general debility related to a chronic disease. Evidence: TAS. Frequency: Very frequent (HP:0040281). (ORPHA:93941)
- Abnormal rib morphology (HP:0000772): An anomaly of the rib. Evidence: TAS. Frequency: Frequent (HP:0040282). (ORPHA:93941)
- Laryngomalacia (HP:0001601): Laryngomalacia is a congenital abnormality of the laryngeal cartilage in which the cartilage is floppy and prolapses over the larynx during inspiration. Evidence: TAS. Frequency: Frequent (HP:0040282). (ORPHA:93941)
- Abnormal cardiac septum morphology (HP:0001671): An anomaly of the intra-atrial or intraventricular septum. Evidence: TAS. Frequency: Frequent (HP:0040282). (ORPHA:93941)
- Abnormality of the spleen (HP:0001743): An abnormality of the spleen. Evidence: TAS. Frequency: Frequent (HP:0040282). (ORPHA:93941)
- Abnormal lower motor neuron morphology (HP:0002366): Any structural anomaly of the lower motor neuron. Evidence: TAS. Frequency: Frequent (HP:0040282). (ORPHA:93941)
- Tracheoesophageal fistula (HP:0002575): An abnormal connection (fistula) between the esophagus and the trachea. Evidence: TAS. Frequency: Frequent (HP:0040282). (ORPHA:93941)
- Tracheal stenosis (HP:0002777). Evidence: TAS. Frequency: Frequent (HP:0040282). (ORPHA:93941)
- Intestinal atresia (HP:0011100): An abnormal closure, or atresia of the tubular structure of the intestine. Evidence: TAS. Frequency: Frequent (HP:0040282). (ORPHA:93941)
- Abnormal mesentery morphology (HP:0100016): Folds of membranous tissue (peritoneum, mesothelium) attached to the wall of the abdomen and enclosing viscera. Examples include the mesentery for the small intestine; the transverse mesocolon, which attaches the transverse portion of the colon to the back wall of the abdomen; and the mesosigmoid, which enfolds the sigmoid portion of the colon. Cells of the same embryologic origin also surround the other organs of the body such as the lungs (pleura) or the heart (pericardium). Evidence: TAS. Frequency: Frequent (HP:0040282). (ORPHA:93941)
These phenotypes are associated with the disease Laryngotracheoesophageal cleft type 4 (ORPHA:93941).